Phenotypes associated with the disease Stevenson-Carey syndrome (OMIM:611961):
- Anteverted nares (HP:0000463): Anteriorly-facing nostrils viewed with the head in the Frankfurt horizontal and the eyes of the observer level with the eyes of the subject. This gives the appearance of an upturned nose (upturned nasal tip). Evidence: IEA. (OMIM:611961)
- Seizure (HP:0001250): A seizure is an intermittent abnormality of nervous system physiology characterized by a transient occurrence of signs and/or symptoms due to abnormal excessive or synchronous neuronal activity in the brain. Evidence: IEA. (OMIM:611961)
- Narrow mouth (HP:0000160): Distance between the commissures of the mouth more than 2 SD below the mean. Alternatively, an apparently decreased width of the oral aperture (subjective). Evidence: IEA. (OMIM:611961)
- Gastroesophageal reflux (HP:0002020): A condition in which the stomach contents leak backwards from the stomach into the esophagus through the lower esophageal sphincter. Evidence: IEA. (OMIM:611961)
- Prominent nasal tip (HP:0005274). Evidence: IEA. (OMIM:611961)
- Enlarged cisterna magna (HP:0002280): Increase in size of the cisterna magna, one of three principal openings in the subarachnoid space between the arachnoid and pia mater, located between the cerebellum and the dorsal surface of the medulla oblongata. Evidence: IEA. (OMIM:611961)
- Downturned corners of mouth (HP:0002714): A morphological abnormality of the mouth in which the angle of the mouth is downturned. The oral commissures are positioned inferior to the midline labial fissure. Evidence: IEA. (OMIM:611961)
- Constipation (HP:0002019): Infrequent or difficult evacuation of feces. Evidence: IEA. (OMIM:611961)
- Posteriorly rotated ears (HP:0000358): A type of abnormal location of the ears in which the position of the ears is characterized by posterior rotation (the superior part of the ears is rotated towards the back of the head, and the inferior part of the ears towards the front). Evidence: IEA. (OMIM:611961)
- Intellectual disability (HP:0001249): The term intellectual disability or intellectual developmental disorder is used to describe significantly sub-average intellectual and adaptive functioning based on clinical assessment and as measured by individually administered, appropriately normed, standardized and validated tests of intellectual functioning and adaptive behavior, with onset during the developmental period from infancy through adolescence. Evidence: IEA. (OMIM:611961)
- Recurrent urinary tract infections (HP:0000010): Repeated infections of the urinary tract. Evidence: IEA. (OMIM:611961)
- Downslanted palpebral fissures (HP:0000494): The palpebral fissure inclination is more than two standard deviations below the mean. Evidence: IEA. (OMIM:611961)
- Hip dysplasia (HP:0001385): The presence of developmental dysplasia of the hip. Evidence: IEA. (OMIM:611961)
- Scoliosis (HP:0002650): The presence of an abnormal lateral curvature of the spine. Evidence: IEA. (OMIM:611961)
- Underdeveloped nasal alae (HP:0000430): Thinned, deficient, or excessively arched ala nasi. Evidence: IEA. (OMIM:611961)
- Cerebellar hypoplasia (HP:0001321): Cerebellar hypoplasia is a descriptive term implying a cerebellum with a reduced volume, but a normal shape and is stable over time. Evidence: IEA. (OMIM:611961)
- Hypoplasia of the corpus callosum (HP:0002079): Underdevelopment of the corpus callosum. Evidence: TAS. (OMIM:611961)
- Global developmental delay (HP:0001263): A delay in the achievement of motor or mental milestones in the domains of development of a child, including motor skills, speech and language, cognitive skills, and social and emotional skills. This term should only be used to describe children younger than five years of age. Evidence: IEA. (OMIM:611961)
- Camptodactyly (HP:0012385): The distal interphalangeal joint and/or the proximal interphalangeal joint of the fingers or toes cannot be extended to 180 degrees by either active or passive extension. Evidence: TAS. (OMIM:611961)
- Joint contracture of the hand (HP:0009473): Contractures of one ore more joints of the hands meaning chronic loss of joint motion due to structural changes in non-bony tissue. Evidence: IEA. (OMIM:611961)
- Central hypoventilation (HP:0007110). Evidence: IEA. (OMIM:611961)
- Left superior vena cava draining to coronary sinus (HP:0011670): A persistent left superior vena cava (PLSVC) that drains into the right atrium via the coronary sinus. This is the case in 80-92% of cases of PLSVC and results in no hemodynamic consequence. Evidence: TAS. (OMIM:611961)
- Autosomal recessive inheritance (HP:0000007): A mode of inheritance that is observed for traits related to a gene encoded on one of the autosomes (i.e., the human chromosomes 1-22) in which a trait manifests in individuals with two pathogenic alleles, either homozygotes (two copies of the same mutant allele) or compound heterozygotes (whereby each copy of a gene has a distinct mutant allele). Evidence: IEA. (OMIM:611961)
- Microphthalmia (HP:0000568): A developmental anomaly characterized by abnormal smallness of one or both eyes. Evidence: IEA. (OMIM:611961)
- Pierre-Robin sequence (HP:0000201): Pierre Robin malformation is a sequence of developmental malformations characterized by micrognathia (mandibular hypoplasia), glossoptosis and cleft palate. Evidence: IEA. (OMIM:611961)
- Atrial septal defect (HP:0001631): Atrial septal defect (ASD) is a congenital abnormality of the interatrial septum that enables blood flow between the left and right atria via the interatrial septum. Evidence: IEA. (OMIM:611961)
- Brachycephaly (HP:0000248): An abnormality of skull shape characterized by a decreased anterior-posterior diameter. That is, a cephalic index greater than 81%. Alternatively, an apparently shortened anteroposterior dimension (length) of the head compared to width. Evidence: IEA. (OMIM:611961)
- Low-set ears (HP:0000369): Upper insertion of the ear to the scalp below an imaginary horizontal line drawn between the inner canthi of the eye and extending posteriorly to the ear. Evidence: IEA. (OMIM:611961)
- Coloboma (HP:0000589): A developmental defect characterized by a cleft of some portion of the eye or ocular adnexa. Evidence: IEA. (OMIM:611961)